Phenotypes associated with the disease premature ovarian failure 9 (OMIM:615724):
- Premature ovarian insufficiency (HP:0008209): Amenorrhea due to loss of ovarian function before the age of 40. Primary ovarian insuficiency (POI) is a state of female hypergonadotropic hypogonadism. It can manifest as primary amenorrhea with onset before menarche or secondary amenorrhea. Evidence: PCS. Frequency: 3/3. (PMID:24597873)
- Elevated circulating luteinizing hormone level (HP:0011969): An elevated concentration of luteinizing hormone in the blood. Evidence: PCS. Frequency: 3/3. (PMID:24597873)
- Amenorrhea (HP:0000141): Absence of menses for an interval of time equivalent to a total of more than (or equal to) 3 previous cycles or 6 months. Evidence: PCS. Frequency: 3/3. (PMID:24597873)
- Young adult onset (HP:0011462): Onset of disease at the age of between 16 and 40 years. Evidence: PCS. Frequency: 3/3. (PMID:24597873)
- Elevated circulating follicle stimulating hormone level (HP:0008232): An elevated concentration of follicle-stimulating hormone in the blood. Evidence: PCS. Frequency: 3/3. (PMID:24597873)
- Autosomal recessive inheritance (HP:0000007): A mode of inheritance that is observed for traits related to a gene encoded on one of the autosomes (i.e., the human chromosomes 1-22) in which a trait manifests in individuals with two pathogenic alleles, either homozygotes (two copies of the same mutant allele) or compound heterozygotes (whereby each copy of a gene has a distinct mutant allele). Evidence: PCS. (PMID:24597873)
- Hypoplasia of the ovary (HP:0008724): Developmental hypoplasia of the ovary. Evidence: PCS. Frequency: 3/3. (PMID:24597873)